Phenotypes associated with the disease commissural lip pits (OMIM:120500):
- Preauricular pit (HP:0004467): Small indentation anterior to the insertion of the ear. Evidence: IEA. (OMIM:120500)
- Autosomal dominant inheritance (HP:0000006): A mode of inheritance that is observed for traits related to a gene encoded on one of the autosomes (i.e., the human chromosomes 1-22) in which a trait manifests in heterozygotes. In the context of medical genetics, an autosomal dominant disorder is caused when a single copy of the mutant allele is present. Males and females are affected equally, and can both transmit the disorder with a risk of 50% for each child of inheriting the mutant allele. Evidence: IEA. (OMIM:120500)
- Commissural lip pit (HP:0002710): A depression located at an oral commissure. Evidence: IEA. (OMIM:120500)